Phenotypes associated with the disease developmental dysplasia of the hip 1 (OMIM:142700):
- Congenital hip dislocation (HP:0001374). Evidence: IEA. (OMIM:142700)
- Acetabular dysplasia (HP:0008807): A smaller than normal acetabulum that has insufficient femoral head coverage leading to abnormal hip joint contact pressures, instability and pain. Evidence: IEA. (OMIM:142700)
- Non-Mendelian inheritance (HP:0001426): A mode of inheritance that depends on genetic determinants in more than one gene. Evidence: IEA. (OMIM:142700)